Phenotypes associated with the disease Schöpf-Schulz-Passarge syndrome (ORPHA:50944):
- Ectodermal dysplasia (HP:0000968): Ectodermal dysplasia is a group of conditions in which there is abnormal development of the skin, hair, nails, teeth, or sweat glands. Evidence: TAS. Frequency: Very frequent (HP:0040281). (ORPHA:50944)
- Palmoplantar keratoderma (HP:0000982): Abnormal thickening of the skin of the palms of the hands and the soles of the feet. Evidence: TAS. Frequency: Very frequent (HP:0040281). (ORPHA:50944)
- Facial telangiectasia (HP:0007380): Telangiectases (small dilated blood vessels) located near the surface of the skin of the face. Evidence: TAS. Frequency: Very frequent (HP:0040281). (ORPHA:50944)
- Sparse hair (HP:0008070): Reduced density of hairs. Evidence: TAS. Frequency: Very frequent (HP:0040281). (ORPHA:50944)
- Hypodontia (HP:0000668): The absence of five or less teeth from the normal series by a failure to develop. Evidence: TAS. Frequency: Frequent (HP:0040282). (ORPHA:50944)
- Alopecia (HP:0001596): A noncongenital process of hair loss, which may progress to partial or complete baldness. Evidence: TAS. Frequency: Frequent (HP:0040282). (ORPHA:50944)
- Premature loss of primary teeth (HP:0006323): Loss of the primary (also known as deciduous) teeth before the usual age. Evidence: TAS. Frequency: Frequent (HP:0040282). (ORPHA:50944)
- Aplasia/Hypoplasia of the eyebrow (HP:0100840): Absence or underdevelopment of the eyebrow. Evidence: TAS. Frequency: Frequent (HP:0040282). (ORPHA:50944)
- Bird-like facies (HP:0000320). Evidence: TAS. Frequency: Occasional (HP:0040283). (ORPHA:50944)
- Basal cell carcinoma (HP:0002671): The presence of a basal cell carcinoma of the skin. Evidence: TAS. Frequency: Occasional (HP:0040283). (ORPHA:50944)
- Squamous cell carcinoma (HP:0002860): The presence of squamous cell carcinoma of the skin. Evidence: TAS. Frequency: Occasional (HP:0040283). (ORPHA:50944)
- Ovarian neoplasm (HP:0100615): A tumor (abnormal growth of tissue) of the ovary. Evidence: TAS. Frequency: Occasional (HP:0040283). (ORPHA:50944)